Phenotypes associated with the disease combined immunodeficiency, X-linked (OMIM:312863):
- Combined immunodeficiency (HP:0005387): A group of phenotypically heterogeneous genetic disorders characterized by profound deficiencies of T- and B-cell function, which predispose the patients to both infectious and noninfectious complications. Evidence: TAS. Frequency: 1/1. (OMIM:312863)
- Infantile onset (HP:0003593): Onset of signs or symptoms of disease between 28 days to one year of life. Evidence: PCS. Frequency: 1/1. (PMID:9399950)
- Abnormal total T cell number (HP:0011839): Abnormal increase or decrease of absolute number (either count per volume or proportion of total lymphocytes) of T cells or of a subset of T cells, commonly characterized as CD3+ lymphocytes, in the blood, compared to a reference range for a given sex and age-group. These may include both TCR alpha/beta and gamma/delta T cells. Evidence: PCS. Frequency: 0/1. (PMID:9399950)
- Pneumonia (HP:0002090): Inflammation of any part of the lung parenchyma. Evidence: IEA. (OMIM:312863)
- Abnormal total B cell count (HP:0010975): The absolute number of B cells in the blood, per microlitre is outside the limits of normal of the reference range for the appropriate sex and age-group. Evidence: PCS. Frequency: 0/1. (PMID:9399950)
- Decreased total CD4+ T cell proportion (HP:0032218): Abnormal decrease of helper CD3+CD4+ T cells, measured as percentage of total CD3+ T cells in the blood, compared to a reference range for a given sex and age-group. These are usually measured within the TCR alpha/beta positive population. Evidence: IEA. (OMIM:312863)
- X-linked recessive inheritance (HP:0001419): A mode of inheritance that is observed for recessive traits related to a gene encoded on the X chromosome. In the context of medical genetics, X-linked recessive disorders manifest in males (who have one copy of the X chromosome and are thus hemizygotes), but generally not in female heterozygotes who have one mutant and one normal allele. Evidence: PCS. (PMID:8462096)
- Abnormal total natural killer cell count (HP:0040089): Abnormal increase or decrease of total natural killer (NK) cells, commonly characterized as CD3-CD19- and CD16+ or CD56+ lymphocytes, in the blood, per microlitre, or altered NK cell phenotype, compared to a reference range for a given sex and age-group, measured ex vivo. Evidence: PCS. Frequency: 0/1. (PMID:9399950)
- Recurrent bronchitis (HP:0002837): An increased susceptibility to bronchitis as manifested by a history of recurrent bronchitis. Evidence: IEA. (OMIM:312863)
- Pneumocystis jirovecii pneumonia (HP:0020102): An opportunistic disease caused by invasion of unicellular fungus Pneumocystis jirovecii. Transmission of P. jirovecii cysts takes place through the airborne route, and usually, its presence in lungs is asymptomatic. However, people with impaired immunity, especially those with CD4+ T cell count below 200/microliter, are still at risk of the development of Pneumocystis pneumonia due to P. jirovecii invasion. Symptoms induced by this disease are not specific: progressive dyspnea, non-productive cough, low-grade fever, arterial partial pressure of oxygen below 65 mmHg, and chest radiographs demonstrating bilateral, interstitial shadowing. Evidence: PCS. Frequency: 1/1. (PMID:9399950)
- Sinusitis (HP:0000246): Inflammation of the paranasal sinuses owing to a viral, bacterial, or fungal infection, allergy, or an autoimmune reaction. Evidence: IEA. (OMIM:312863)
- Otitis media (HP:0000388): Inflammation or infection of the middle ear. Evidence: IEA. (OMIM:312863)
- Decreased circulating IgG concentration (HP:0004315): An abnormally decreased level of immunoglobulin G (IgG) in blood. Evidence: PCS. Frequency: 0/1. (PMID:9399950)
- Decreased total CD8+ T cell proportion (HP:0005415): Abnormal decrease of cytotoxic CD3+CD8+ T cells, measured as percentage of total CD3+ T cells in the blood, compared to a reference range for a given sex and age-group. These are usually measured within the TCR alpha/beta positive population. Evidence: IEA. (OMIM:312863)